Phenotypes associated with the disease Pressure-induced localized lipoatrophy (ORPHA:90160):
- Lipoatrophy (HP:0100578): Localized loss of fat tissue. Evidence: TAS. Frequency: Obligate (HP:0040280). (ORPHA:90160)
- Reduced subcutaneous adipose tissue (HP:0003758): A reduced amount of fat tissue in the lowest layer of the integument. This feature can be appreciated by a reduced skinfold thickness. Evidence: TAS. Frequency: Very frequent (HP:0040281). (ORPHA:90160)
- Regional abnormality of skin (HP:0011356): An abnormality of the skin that is restricted to a particular body region. Evidence: TAS. Frequency: Very frequent (HP:0040281). (ORPHA:90160)
- Absence of subcutaneous fat (HP:0007485): Lack of subcutaneous adipose tissue. Evidence: TAS. Frequency: Frequent (HP:0040282). (ORPHA:90160)
- Erythema (HP:0010783): Redness of the skin, caused by hyperemia of the capillaries in the lower layers of the skin. Evidence: TAS. Frequency: Frequent (HP:0040282). (ORPHA:90160)
- Inflammatory abnormality of the skin (HP:0011123): The presence of inflammation of the skin. That is, an abnormality of the skin resulting from the local accumulation of fluid, plasma proteins, and leukocytes. Evidence: TAS. Frequency: Frequent (HP:0040282). (ORPHA:90160)
- Skin nodule (HP:0200036): Morphologically similar to a papule, but greater than either 10mm in both width and depth, and most frequently centered in the dermis or subcutaneous fat. Evidence: TAS. Frequency: Frequent (HP:0040282). (ORPHA:90160)